Phenotypes associated with the disease Non-syndromic posterior hypospadias (ORPHA:95706):
- Displacement of the urethral meatus (HP:0100627): A displacement of the external urethral orifice from its normal position (in males normally placed at the tip of glans penis, in females normally placed about 2.5 cm behind the glans clitoridis and immediately in front of that of the vagina). Evidence: TAS. Frequency: Very frequent (HP:0040281). (ORPHA:95706)
- Cryptorchidism (HP:0000028): Testis in inguinal canal. That is, absence of one or both testes from the scrotum owing to failure of the testis or testes to descend through the inguinal canal to the scrotum. Evidence: TAS. Frequency: Frequent (HP:0040282). (ORPHA:95706)
- Ventral shortening of foreskin (HP:0012435): Reduction in length of the ventral (lower) skin of prepuce of penis. Evidence: TAS. Frequency: Frequent (HP:0040282). (ORPHA:95706)
- Bifid scrotum (HP:0000048): Midline indentation or cleft of the scrotum. Evidence: TAS. Frequency: Occasional (HP:0040283). (ORPHA:95706)
- Micropenis (HP:0000054): Abnormally small penis. At birth, the normal penis is about 3 cm (stretched length from pubic tubercle to tip of penis) with micropenis less than 2.0-2.5 cm. Evidence: TAS. Frequency: Occasional (HP:0040283). (ORPHA:95706)
- Cleft palate (HP:0000175): Cleft palate is a developmental defect of the palate resulting from a failure of fusion of the palatine processes and manifesting as a separation of the roof of the mouth (soft and hard palate). Evidence: TAS. Frequency: Occasional (HP:0040283). (ORPHA:95706)
- Depression (HP:0000716): Frequently experiencing feelings of being down, miserable, and/or hopeless; struggling to recover from these moods; having a pessimistic outlook on the future; feeling a pervasive sense of shame; having a low self-worth; experiencing thoughts of suicide and engaging in suicidal behavior. Evidence: TAS. Frequency: Occasional (HP:0040283). (ORPHA:95706)
- Anxiety (HP:0000739): Intense feelings of nervousness, tension, or panic often arise in response to interpersonal stresses. There is worry about the negative effects of past unpleasant experiences and future negative possibilities. Individuals may feel fearful, apprehensive, or threatened by uncertainty, and they may also have fears of falling apart or losing control. Evidence: TAS. Frequency: Occasional (HP:0040283). (ORPHA:95706)
- Congenital diaphragmatic hernia (HP:0000776): The presence of a hernia of the diaphragm present at birth. Evidence: TAS. Frequency: Occasional (HP:0040283). (ORPHA:95706)
- Abnormality of the endocrine system (HP:0000818): An abnormality of the endocrine system. Evidence: TAS. Frequency: Occasional (HP:0040283). (ORPHA:95706)
- Omphalocele (HP:0001539): A midline anterior incomplete closure of the abdominal wall in which there is herniation of the abdominal viscera into the base of the abdominal cord. Evidence: TAS. Frequency: Occasional (HP:0040283). (ORPHA:95706)
- Anal atresia (HP:0002023): Congenital absence of the anus, i.e., the opening at the bottom end of the intestinal tract. Evidence: TAS. Frequency: Occasional (HP:0040283). (ORPHA:95706)
- Esophageal atresia (HP:0002032): A developmental defect resulting in complete obliteration of the lumen of the esophagus such that the esophagus ends in a blind pouch rather than connecting to the stomach. Evidence: TAS. Frequency: Occasional (HP:0040283). (ORPHA:95706)
- Androgen insufficiency (HP:0008226): Insufficient amount of androgenic activity. Evidence: TAS. Frequency: Occasional (HP:0040283). (ORPHA:95706)
- Small for gestational age (HP:0001518): Smaller than normal size according to sex and gestational age related norms, defined as a weight below the 10th percentile for the gestational age. Evidence: TAS. Frequency: Very rare (HP:0040284). (ORPHA:95706)
- Urethral diverticulum (HP:0008722): The presence of a diverticulum (sac or pouch) in the wall of the urethra. Evidence: TAS. Frequency: Very rare (HP:0040284). (ORPHA:95706)